- Congenital ptosis (HP:0007970). Evidence: IEA. (OMIM:178300)
- Autosomal dominant inheritance (HP:0000006): A mode of inheritance that is observed for traits related to a gene encoded on one of the autosomes (i.e., the human chromosomes 1-22) in which a trait manifests in heterozygotes. In the context of medical genetics, an autosomal dominant disorder is caused when a single copy of the mutant allele is present. Males and females are affected equally, and can both transmit the disorder with a risk of 50% for each child of inheriting the mutant allele. Evidence: IEA. (OMIM:178300)
These phenotypes are associated with the disease ptosis, hereditary congenital, 1 (OMIM:178300).